- Paraganglioma (HP:0002668): A carotid body tumor (also called paraganglionoma or chemodectoma) is a tumor found in the upper neck at the branching of the carotid artery. They arise from the chemoreceptor organ (paraganglion) located in the adventitia of the carotid artery bifurcation. Evidence: TAS. Frequency: Very frequent (HP:0040281). (ORPHA:276621)
- Extraadrenal pheochromocytoma (HP:0006737): Pheochromocytoma not originating from the adrenal medulla but from another source such as from chromaffin cells in or about sympathetic ganglia. Evidence: TAS. Frequency: Very frequent (HP:0040281). (ORPHA:276621)
- Adrenal pheochromocytoma (HP:0006748): Pheochromocytoma originating from the adrenal medulla. Evidence: TAS. Frequency: Very frequent (HP:0040281). (ORPHA:276621)
- Proteinuria (HP:0000093): Increased levels of protein in the urine. Evidence: TAS. Frequency: Frequent (HP:0040282). (ORPHA:276621)
- Glomerular sclerosis (HP:0000096): Accumulation of scar tissue within the glomerulus. Evidence: TAS. Frequency: Frequent (HP:0040282). (ORPHA:276621)
- Episodic paroxysmal anxiety (HP:0000740): Recurrent attacks of severe anxiety, which occur without restriction to any particular situation or set of circumstances, are therefore unpredictable. Evidence: TAS. Frequency: Frequent (HP:0040282). (ORPHA:276621)
- Episodic hyperhidrosis (HP:0001069): Intermittent episodes of abnormally increased perspiration. Evidence: TAS. Frequency: Frequent (HP:0040282). (ORPHA:276621)
- Hypertensive retinopathy (HP:0001095): Condition of the retina, secondary to severe systemic arterial hypertension which can be acute or longstanding. Features include one or several of the following: retinal vascular tortuosity, arteriovenous crossing signs, retinal cotton wool spot and intraretinal hemorrhages. It can be associated with optic disc swelling. Evidence: TAS. Frequency: Frequent (HP:0040282). (ORPHA:276621)
- Cerebral hemorrhage (HP:0001342): Hemorrhage into the parenchyma of the brain. Evidence: TAS. Frequency: Frequent (HP:0040282). (ORPHA:276621)
- Dysphonia (HP:0001618): Difficulty in speaking due to a physical disorder of the mouth, tongue, throat, or vocal cords. Associated with a known physical or neurological cause. Evidence: TAS. Frequency: Frequent (HP:0040282). (ORPHA:276621)
- Weight loss (HP:0001824): Reduction of total body weight. Evidence: TAS. Frequency: Frequent (HP:0040282). (ORPHA:276621)
- Palpitations (HP:0001962): A sensation that the heart is pounding or racing, which is a non-specific sign but may be a manifestation of arrhythmia. Evidence: TAS. Frequency: Frequent (HP:0040282). (ORPHA:276621)
- Nausea (HP:0002018): A sensation of unease in the stomach together with an urge to vomit. Evidence: TAS. Frequency: Frequent (HP:0040282). (ORPHA:276621)
- Recurrent paroxysmal headache (HP:0002331): Repeated episodes of headache with rapid onset, reaching a peak within minutes and of short duration (less than one hour) with pain that is throbbing, pulsating, or bursting in quality. Evidence: TAS. Frequency: Frequent (HP:0040282). (ORPHA:276621)
- Episodic abdominal pain (HP:0002574): An intermittent form of abdominal pain. Evidence: TAS. Frequency: Frequent (HP:0040282). (ORPHA:276621)
- Hypertension associated with pheochromocytoma (HP:0002640): A type of hypertension associated with pheochromocytoma. Evidence: TAS. Frequency: Frequent (HP:0040282). (ORPHA:276621)
- Paraganglioma of head and neck (HP:0002864). Evidence: TAS. Frequency: Frequent (HP:0040282). (ORPHA:276621)
- Hypercalcemia (HP:0003072): The concentration of calcium in the blood circulation is above the upper limit of normal. Evidence: TAS. Frequency: Frequent (HP:0040282). (ORPHA:276621)
- Elevated urinary norepinephrine level (HP:0003345): The concentration of noradrenaline in the urine, normalized for urine concentration, is above the upper limit of normal. Evidence: TAS. Frequency: Frequent (HP:0040282). (ORPHA:276621)
- Positive regitine blocking test (HP:0003574): A positive response to the regitine blocking test consisting of a substantial reduction in blood pressure following administration of regitine, indicative of the presence of increased levels of epinephrine and norepinephrine in the circulation, which is seen in pheochromocytoma-associated hypertension. Evidence: TAS. Frequency: Frequent (HP:0040282). (ORPHA:276621)
- Elevated urinary epinephrine level (HP:0003639): The concentration of epinephrine in the urine, normalized for urine concentration, is above the upper limit of normal. Evidence: TAS. Frequency: Frequent (HP:0040282). (ORPHA:276621)
- Pulsatile tinnitus (HP:0008629): Pulsatile tinnitus is generally classified a kind of objective tinnitus, meaning that it is not only audible to the patient but also to the examiner on auscultation of the auditory canal and/or of surrounding structures with use of an auscultation tube or stethoscope. Usually, pulsatile tinnitus is heard as a lower pitched thumping or booming, a rougher blowing sound which is coincidental with respiration, or as a clicking, higher pitched rhythmic sensation. Evidence: TAS. Frequency: Frequent (HP:0040282). (ORPHA:276621)
- Paroxysmal vertigo (HP:0010532): Paroxysmal episodes of vertigo. Evidence: TAS. Frequency: Frequent (HP:0040282). (ORPHA:276621)
- Sinus tachycardia (HP:0011703): Heart rate of greater than 100 beats per minute. Evidence: TAS. Frequency: Frequent (HP:0040282). (ORPHA:276621)
- Elevated urinary dopamine level (HP:0011979): The concentration of dopamine in the urine, normalized for urine concentration, is above the upper limit of normal. Evidence: TAS. Frequency: Frequent (HP:0040282). (ORPHA:276621)
- Fatigue (HP:0012378): A subjective feeling of tiredness characterized by a lack of energy and motivation. Evidence: TAS. Frequency: Frequent (HP:0040282). (ORPHA:276621)
- Flushing (HP:0031284): Recurrent episodes of redness of the skin together with a sensation of warmth or burning of the affected areas of skin. Evidence: TAS. Frequency: Frequent (HP:0040282). (ORPHA:276621)
- Chest pain (HP:0100749): An unpleasant sensation characterized by physical discomfort (such as pricking, throbbing, or aching) localized to the chest. Evidence: TAS. Frequency: Frequent (HP:0040282). (ORPHA:276621)
- Conductive hearing impairment (HP:0000405): An abnormality of vibrational conductance of sound to the inner ear leading to impairment of sensory perception of sound. Evidence: TAS. Frequency: Occasional (HP:0040283). (ORPHA:276621)
- Hematuria (HP:0000790): The presence of blood in the urine. Hematuria may be gross hematuria (visible to the naked eye) or microscopic hematuria (detected by dipstick or microscopic examination of the urine). Evidence: TAS. Frequency: Occasional (HP:0040283). (ORPHA:276621)
- Pallor (HP:0000980): Abnormally pale skin. Evidence: TAS. Frequency: Occasional (HP:0040283). (ORPHA:276621)
- Cranial nerve compression (HP:0001293). Evidence: TAS. Frequency: Occasional (HP:0040283). (ORPHA:276621)
- Tremor (HP:0001337): An unintentional, oscillating to-and-fro muscle movement about a joint axis. Evidence: TAS. Frequency: Occasional (HP:0040283). (ORPHA:276621)
- Vocal cord paralysis (HP:0001605): A loss of the ability to move the vocal folds. Evidence: TAS. Frequency: Occasional (HP:0040283). (ORPHA:276621)
- Congestive heart failure (HP:0001635): The presence of an abnormality of cardiac function that is responsible for the failure of the heart to pump blood at a rate that is commensurate with the needs of the tissues or a state in which abnormally elevated filling pressures are required for the heart to do so. Heart failure is frequently related to a defect in myocardial contraction. Evidence: TAS. Frequency: Occasional (HP:0040283). (ORPHA:276621)
- Panic attack (HP:0025269): A sudden episode of intense fear in a situation where there is no danger or apparent cause. Evidence: TAS. Frequency: Occasional (HP:0040283). (ORPHA:276621)
These phenotypes are associated with the disease Sporadic pheochromocytoma/secreting paraganglioma (ORPHA:276621).